Phenotypes associated with the disease Bilateral frontoparietal polymicrogyria (ORPHA:101070):
- Intellectual disability (HP:0001249): The term intellectual disability or intellectual developmental disorder is used to describe significantly sub-average intellectual and adaptive functioning based on clinical assessment and as measured by individually administered, appropriately normed, standardized and validated tests of intellectual functioning and adaptive behavior, with onset during the developmental period from infancy through adolescence. Evidence: TAS. Frequency: Very frequent (HP:0040281). (ORPHA:101070)
- Seizure (HP:0001250): A seizure is an intermittent abnormality of nervous system physiology characterized by a transient occurrence of signs and/or symptoms due to abnormal excessive or synchronous neuronal activity in the brain. Evidence: TAS. Frequency: Very frequent (HP:0040281). (ORPHA:101070)
- Motor delay (HP:0001270): A type of Developmental delay characterized by a delay in acquiring motor skills. Evidence: TAS. Frequency: Very frequent (HP:0040281). (ORPHA:101070)
- Ventriculomegaly (HP:0002119): An increase in size of the ventricular system of the brain. Evidence: TAS. Frequency: Very frequent (HP:0040281). (ORPHA:101070)
- Cortical dysplasia (HP:0002539): The presence of developmental dysplasia of the cerebral cortex. Evidence: TAS. Frequency: Very frequent (HP:0040281). (ORPHA:101070)
- Cerebellar dysplasia (HP:0007033): Cerebellar dysplasia (abnormal growth or development) is defined by abnormal cerebellar foliation, white matter arborization, and gray-white matter junction. Cerebellar dysplasia is a neuroimaging finding that describes abnormalities of both the cerebellar cortex and white matter and is associated with variable neurodevelopmental outcome. Dysplasia may globally involve the cerebellum or affect only one cerebellar hemisphere. In addition, cerebellar dysplasia may be associated with cortical/subcortical cysts. Evidence: TAS. Frequency: Very frequent (HP:0040281). (ORPHA:101070)
- Cerebral dysmyelination (HP:0007266): Defective structure and function of myelin sheaths of the white matter of the brain. Evidence: TAS. Frequency: Very frequent (HP:0040281). (ORPHA:101070)
- Esotropia (HP:0000565): A form of strabismus with one or both eyes turned inward ('crossed') to a relatively severe degree, usually defined as 10 diopters or more. Evidence: TAS. Frequency: Frequent (HP:0040282). (ORPHA:101070)
- Global developmental delay (HP:0001263): A delay in the achievement of motor or mental milestones in the domains of development of a child, including motor skills, speech and language, cognitive skills, and social and emotional skills. This term should only be used to describe children younger than five years of age. Evidence: TAS. Frequency: Frequent (HP:0040282). (ORPHA:101070)
- Abnormal cerebellum morphology (HP:0001317): Any structural abnormality of the cerebellum. Evidence: TAS. Frequency: Frequent (HP:0040282). (ORPHA:101070)
- Cerebellar vermis hypoplasia (HP:0001320): Underdevelopment of the vermis of cerebellum. Evidence: TAS. Frequency: Frequent (HP:0040282). (ORPHA:101070)
- Gait imbalance (HP:0002141). Evidence: TAS. Frequency: Frequent (HP:0040282). (ORPHA:101070)
- Language impairment (HP:0002463): Language impairment is a deficit in comprehension or production of language that includes reduced vocabulary, limited sentence structure, or impairments in written or spoken communication. Language abilities are substantially and quantifiably below age expectations. Evidence: TAS. Frequency: Frequent (HP:0040282). (ORPHA:101070)
- Abnormal pyramidal sign (HP:0007256): Functional neurological abnormalities related to dysfunction of the pyramidal tract. Evidence: TAS. Frequency: Frequent (HP:0040282). (ORPHA:101070)
- Severe intellectual disability (HP:0010864): Severe intellectual disability (ID) is defined as a type of ID characterized by severely sub-average adaptive functioning and intellectual functioning, with an intelligence quotient (IQ) the range of 20-34. Evidence: TAS. Frequency: Frequent (HP:0040282). (ORPHA:101070)
- Hypoplasia of the pons (HP:0012110): Underdevelopment of the pons. Evidence: TAS. Frequency: Frequent (HP:0040282). (ORPHA:101070)
- Bilateral tonic-clonic seizure with generalized onset (HP:0025190): A bilateral tonic-clonic seizure with generalized onset is a type of bilateral tonic-clonic seizure characterized by generalized onset; these seizures rapidly engage networks in both hemispheres at the start of the seizure. Evidence: TAS. Frequency: Frequent (HP:0040282). (ORPHA:101070)
- Microcephaly (HP:0000252): Head circumference below 2 standard deviations below the mean for age and gender. Evidence: TAS. Frequency: Occasional (HP:0040283). (ORPHA:101070)
- Strabismus (HP:0000486): A misalignment of the eyes so that the visual axes deviate from bifoveal fixation. The classification of strabismus may be based on a number of features including the relative position of the eyes, whether the deviation is latent or manifest, intermittent or constant, concomitant or otherwise and according to the age of onset and the relevance of any associated refractive error. Evidence: TAS. Frequency: Occasional (HP:0040283). (ORPHA:101070)
- Generalized myoclonic seizure (HP:0002123): A generalized myoclonic seizure is a type of generalized motor seizure characterized by bilateral, sudden, brief (<100 ms) involuntary single or multiple contraction of muscles or muscle groups of variable topography (axial, proximal limb, distal). Myoclonus is less regularly repetitive and less sustained than is clonus. Evidence: TAS. Frequency: Occasional (HP:0040283). (ORPHA:101070)
- Hypoplasia of the brainstem (HP:0002365): Underdevelopment of the brainstem. Evidence: TAS. Frequency: Occasional (HP:0040283). (ORPHA:101070)
- Atonic seizure (HP:0010819): Atonic seizure is a type of motor seizure characterized by a sudden loss or diminution of muscle tone without apparent preceding myoclonic or tonic event lasting about 1 to 2 seconds, involving head, trunk, jaw, or limb musculature. Evidence: TAS. Frequency: Occasional (HP:0040283). (ORPHA:101070)
- Typical absence seizure (HP:0011147): A typical absence seizure is a type of generalized non-motor (absence) seizure characterized by its sudden onset, interruption of ongoing activities, a blank stare, possibly a brief upward deviation of the eyes. Usually the patient will be unresponsive when spoken to. Duration is a few seconds to half a minute with very rapid recovery. Although not always available, an EEG would usually show 3 Hz generalized epileptiform discharges during the event. Evidence: TAS. Frequency: Occasional (HP:0040283). (ORPHA:101070)
- Increased head circumference (HP:0040194): An abnormally increased head circumference in a growing child. Head circumference is measured with a nonelastic tape and comprises the distance from above the eyebrows and ears and around the back of the head. The measured HC is then plotted on an appropriate growth chart. Evidence: TAS. Frequency: Occasional (HP:0040283). (ORPHA:101070)